Phenotypes associated with the disease hyperpigmentation of eyelid (OMIM:145100):
- Hyperpigmentation of eyelids (HP:0007406). Evidence: IEA. (OMIM:145100)
- Autosomal dominant inheritance (HP:0000006): A mode of inheritance that is observed for traits related to a gene encoded on one of the autosomes (i.e., the human chromosomes 1-22) in which a trait manifests in heterozygotes. In the context of medical genetics, an autosomal dominant disorder is caused when a single copy of the mutant allele is present. Males and females are affected equally, and can both transmit the disorder with a risk of 50% for each child of inheriting the mutant allele. Evidence: IEA. (OMIM:145100)